Phenotypes associated with the disease hypoglycemia, leucine-induced (OMIM:240800):
- Strabismus (HP:0000486): A misalignment of the eyes so that the visual axes deviate from bifoveal fixation. The classification of strabismus may be based on a number of features including the relative position of the eyes, whether the deviation is latent or manifest, intermittent or constant, concomitant or otherwise and according to the age of onset and the relevance of any associated refractive error. Evidence: IEA. (OMIM:240800)
- Seizure (HP:0001250): A seizure is an intermittent abnormality of nervous system physiology characterized by a transient occurrence of signs and/or symptoms due to abnormal excessive or synchronous neuronal activity in the brain. Evidence: IEA. (OMIM:240800)
- Ataxia (HP:0001251): Ataxia refers to impaired coordination of voluntary muscle movement. Cerebellar ataxia refers to ataxia due to dysfunction of the cerebellum. This causes a variety of elementary neurological deficits including asynergy (lack of coordination between muscles, limbs and joints), dysmetria (lack of ability to judge distances that can lead to under- or overshoot in grasping movements), and dysdiadochokinesia (inability to perform rapid movements requiring antagonizing muscle groups to be switched on and off repeatedly). Evidence: IEA. (OMIM:240800)
- Hyperinsulinemic hypoglycemia (HP:0000825): An increased concentration of insulin combined with a decreased concentration of glucose in the blood. Evidence: PCS. Frequency: 1/1. (PMID:15356046)
- Irritability (HP:0000737): An emotional state characterized by negative feelings of heightened frustration, annoyance, or feeling upset, often triggered by internal factors (e.g., fatigue, hunger, unfulfilled desires) or external factors (e.g., social or environmental challenges). Irritability may be unpredictable, and is accompanied by a lowered threshold for emotional reactivity and observable features (speech, facial expressions, or psychomotor activity). Evidence: TAS. (OMIM:240800)
- Hypoglycemia (HP:0001943): A decreased concentration of glucose in the blood. Evidence: PCS. Frequency: 1/1. Onset: Neonatal onset (HP:0003623). (PMID:15356046)
- Drowsiness (HP:0002329): Abnormal feeling of sleepiness or difficulty staying awake. Evidence: IEA. (OMIM:240800)
- Spasticity (HP:0001257): A motor disorder characterized by a velocity-dependent increase in tonic stretch reflexes with increased muscle tone, exaggerated (hyperexcitable) tendon reflexes. Evidence: IEA. (OMIM:240800)
- Autosomal dominant inheritance (HP:0000006): A mode of inheritance that is observed for traits related to a gene encoded on one of the autosomes (i.e., the human chromosomes 1-22) in which a trait manifests in heterozygotes. In the context of medical genetics, an autosomal dominant disorder is caused when a single copy of the mutant allele is present. Males and females are affected equally, and can both transmit the disorder with a risk of 50% for each child of inheriting the mutant allele. Evidence: PCS. (PMID:15356046)
- Intellectual disability (HP:0001249): The term intellectual disability or intellectual developmental disorder is used to describe significantly sub-average intellectual and adaptive functioning based on clinical assessment and as measured by individually administered, appropriately normed, standardized and validated tests of intellectual functioning and adaptive behavior, with onset during the developmental period from infancy through adolescence. Evidence: IEA. (OMIM:240800)
- Coma (HP:0001259): The complete absence of wakefulness and consciousness, which is evident through a lack of response to any form of external stimuli. Evidence: IEA. (OMIM:240800)
- Hyperreflexia (HP:0001347): Hyperreflexia is the presence of hyperactive stretch reflexes of the muscles. Evidence: TAS. (OMIM:240800)
- Neonatal onset (HP:0003623): Onset of signs or symptoms of disease within the first 28 days of life. Evidence: PCS. Frequency: 1/1. (PMID:15356046)